Phenotypes associated with the disease acrofacial dysostosis, Catania type (OMIM:101805):
- Cerebellar vermis hypoplasia (HP:0001320): Underdevelopment of the vermis of cerebellum. Evidence: PCS. Frequency: 1/1. (PMID:25945454)
- Preauricular pit (HP:0004467): Small indentation anterior to the insertion of the ear. Evidence: TAS. (OMIM:101805)
- Microcephaly (HP:0000252): Head circumference below 2 standard deviations below the mean for age and gender. Evidence: PCS. Frequency: 0/1. (PMID:25945454)
- Downslanted palpebral fissures (HP:0000494): The palpebral fissure inclination is more than two standard deviations below the mean. Evidence: PCS. Frequency: 1/1. (PMID:25945454)
- Cleft palate (HP:0000175): Cleft palate is a developmental defect of the palate resulting from a failure of fusion of the palatine processes and manifesting as a separation of the roof of the mouth (soft and hard palate). Evidence: PCS. Frequency: 0/1. (PMID:25945454)
- Carious teeth (HP:0000670): Caries is a multifactorial bacterial infection affecting the structure of the tooth. This term has been used to describe the presence of more than expected dental caries. Evidence: TAS. (OMIM:101805)
- Short palm (HP:0004279): Short palm. Evidence: TAS. (OMIM:101805)
- Short stature (HP:0004322): A height below that which is expected according to age and gender norms. Although there is no universally accepted definition of short stature, many refer to "short stature" as height more than 2 standard deviations below the mean for age and gender (or below the 3rd percentile for age and gender dependent norms). Evidence: PCS. Frequency: 1/1. (PMID:25945454)
- Hypoplasia of the corpus callosum (HP:0002079): Underdevelopment of the corpus callosum. Evidence: PCS. Frequency: 1/1. (PMID:25945454)
- Brachydactyly (HP:0001156): Digits that appear disproportionately short compared to the hand/foot. The word brachydactyly is used here to describe a series distinct patterns of shortened digits (brachydactyly types A-E). This is the sense used here. Evidence: PCS. Frequency: 1/1. (PMID:25945454)
- Cerebral cortical atrophy (HP:0002120): Atrophy of the cortex of the cerebrum. Evidence: PCS. Frequency: 1/1. (PMID:25945454)
- Spina bifida occulta (HP:0003298): The closed form of spina bifida with incomplete closure of a vertebral body with intact overlying skin. Evidence: PCS. Frequency: 1/1. (PMID:25945454)
- Mandibulofacial dysostosis (HP:0005321): A type of craniofacial dysostosis associated with abnormalities of the external ears, mirognathia, macrostomia, coloboma of the lower eyelid, and cleft palate. This is a bundled term that is left in the HPO now for convenience with legacy annotations but should not be used for new annotations. Evidence: IEA. (OMIM:101805)
- Malar flattening (HP:0000272): Underdevelopment of the malar prominence of the jugal bone (zygomatic bone in mammals), appreciated in profile, frontal view, and/or by palpation. Evidence: PCS. Frequency: 1/1. (PMID:25945454)
- Enlarged cisterna magna (HP:0002280): Increase in size of the cisterna magna, one of three principal openings in the subarachnoid space between the arachnoid and pia mater, located between the cerebellum and the dorsal surface of the medulla oblongata. Evidence: PCS. Frequency: 1/1. (PMID:25945454)
- Widow's peak (HP:0000349): Frontal hairline with bilateral arcs to a low point in the midline of the forehead. Evidence: TAS. (OMIM:101805)
- Single transverse palmar crease (HP:0000954): The distal and proximal transverse palmar creases are merged into a single transverse palmar crease. Evidence: PCS. Frequency: 1/1. (PMID:25945454)
- Prominent nose (HP:0000448): Distance between subnasale and pronasale more than two standard deviations above the mean, or alternatively, an apparently increased anterior protrusion of the nasal tip. Evidence: PCS. Frequency: 1/1. (PMID:25945454)
- Intrauterine growth retardation (HP:0001511): An abnormal restriction of fetal growth with fetal weight below the tenth percentile for gestational age. Evidence: TAS. (OMIM:101805)
- Webbed neck (HP:0000465): Pterygium colli is a congenital skin fold that runs along the sides of the neck down to the shoulders. It involves an ectopic fibrotic facial band superficial to the trapezius muscle. Excess hair-bearing skin is also present and extends down the cervical region well beyond the normal hairline. Evidence: PCS. Frequency: 1/1. (PMID:25945454)
- Hypospadias (HP:0000047): Abnormal position of urethral meatus on the ventral penile shaft (underside) characterized by displacement of the urethral meatus from the tip of the glans penis to the ventral surface of the penis, scrotum, or perineum. Evidence: TAS. (OMIM:101805)
- Micrognathia (HP:0000347): Developmental hypoplasia of the mandible. Evidence: PCS. Frequency: 1/1. (PMID:25945454)
- Cryptorchidism (HP:0000028): Testis in inguinal canal. That is, absence of one or both testes from the scrotum owing to failure of the testis or testes to descend through the inguinal canal to the scrotum. Evidence: TAS. (OMIM:101805)
- Autosomal dominant inheritance (HP:0000006): A mode of inheritance that is observed for traits related to a gene encoded on one of the autosomes (i.e., the human chromosomes 1-22) in which a trait manifests in heterozygotes. In the context of medical genetics, an autosomal dominant disorder is caused when a single copy of the mutant allele is present. Males and females are affected equally, and can both transmit the disorder with a risk of 50% for each child of inheriting the mutant allele. Evidence: TAS. (OMIM:101805)